- Alopecia (HP:0001596): A noncongenital process of hair loss, which may progress to partial or complete baldness. Evidence: TAS. Frequency: Occasional (HP:0040283). (ORPHA:659)
- Osteolysis (HP:0002797): Osteolysis refers to the destruction of bone through bone resorption with removal or loss of calcium. Evidence: TAS. Frequency: Occasional (HP:0040283). (ORPHA:659)
- Melanoma (HP:0002861): The presence of a melanoma, a malignant cancer originating from pigment producing melanocytes. Melanoma can originate from the skin or the pigmented layers of the eye (the uvea). Evidence: TAS. Frequency: Occasional (HP:0040283). (ORPHA:659)
- Neoplasm of the skin (HP:0008069): A tumor (abnormal growth of tissue) of the skin. Evidence: TAS. Frequency: Occasional (HP:0040283). (ORPHA:659)
- Abnormal oral mucosa morphology (HP:0011830): Abnormality of the oral mucosa. Evidence: TAS. Frequency: Occasional (HP:0040283). (ORPHA:659)
- Neoplasm of the lung (HP:0100526): Tumor of the lung. Evidence: TAS. Frequency: Occasional (HP:0040283). (ORPHA:659)
- Anhidrosis (HP:0000970): Inability to sweat. Evidence: TAS. Frequency: Very frequent (HP:0040281). (ORPHA:659)
- Palmoplantar keratoderma (HP:0000982): Abnormal thickening of the skin of the palms of the hands and the soles of the feet. Evidence: TAS. Frequency: Very frequent (HP:0040281). (ORPHA:659)
- Thickened skin (HP:0001072): Laminar thickening of skin. Evidence: TAS. Frequency: Very frequent (HP:0040281). (ORPHA:659)
- Abnormal fingernail morphology (HP:0001231): An abnormality of the fingernails. Evidence: TAS. Frequency: Very frequent (HP:0040281). (ORPHA:659)
- Palmoplantar hyperhidrosis (HP:0007410): An abnormally increased perspiration on palms and soles. Evidence: TAS. Frequency: Very frequent (HP:0040281). (ORPHA:659)
- Sparse hair (HP:0008070): Reduced density of hairs. Evidence: TAS. Frequency: Very frequent (HP:0040281). (ORPHA:659)
- Erythema (HP:0010783): Redness of the skin, caused by hyperemia of the capillaries in the lower layers of the skin. Evidence: TAS. Frequency: Very frequent (HP:0040281). (ORPHA:659)
- Ankylosis (HP:0031013): A reduction of joint mobility resulting from changes involving the articular surfaces. Evidence: TAS. Frequency: Very frequent (HP:0040281). (ORPHA:659)
- Skin fissure (HP:0031057): A clearly-defined and roughly linear cleavage in the skin that usually extends to the dermis. Evidence: TAS. Frequency: Very frequent (HP:0040281). (ORPHA:659)
- Abnormality of the dentition (HP:0000164): Any abnormality of the teeth. Evidence: TAS. Frequency: Frequent (HP:0040282). (ORPHA:659)
- Sensorineural hearing impairment (HP:0000407): A type of hearing impairment in one or both ears related to an abnormal functionality of the cochlear nerve. Evidence: TAS. Frequency: Frequent (HP:0040282). (ORPHA:659)
- Hypodontia (HP:0000668): The absence of five or less teeth from the normal series by a failure to develop. Evidence: TAS. Frequency: Frequent (HP:0040282). (ORPHA:659)
- Carious teeth (HP:0000670): Caries is a multifactorial bacterial infection affecting the structure of the tooth. This term has been used to describe the presence of more than expected dental caries. Evidence: TAS. Frequency: Frequent (HP:0040282). (ORPHA:659)
- Skin ulcer (HP:0200042): A discontinuity of the skin exhibiting complete loss of the epidermis and often portions of the dermis and even subcutaneous fat. Evidence: TAS. Frequency: Frequent (HP:0040282). (ORPHA:659)
- Abnormality of the tongue (HP:0000157): Any abnormality of the tongue. Evidence: TAS. Frequency: Occasional (HP:0040283). (ORPHA:659)
- Abnormality of the gingiva (HP:0000168): Any abnormality of the gingiva (also known as gums). Evidence: TAS. Frequency: Occasional (HP:0040283). (ORPHA:659)
- Seizure (HP:0001250): A seizure is an intermittent abnormality of nervous system physiology characterized by a transient occurrence of signs and/or symptoms due to abnormal excessive or synchronous neuronal activity in the brain. Evidence: TAS. Frequency: Occasional (HP:0040283). (ORPHA:659)
These phenotypes are associated with the disease Mutilating palmoplantar keratoderma with periorificial keratotic plaques (ORPHA:659).